- Posteriorly rotated ears (HP:0000358): A type of abnormal location of the ears in which the position of the ears is characterized by posterior rotation (the superior part of the ears is rotated towards the back of the head, and the inferior part of the ears towards the front). Evidence: TAS. Frequency: Very frequent (HP:0040281). (ORPHA:2059)
- Multicystic kidney dysplasia (HP:0000003): Multicystic dysplasia of the kidney is characterized by multiple cysts of varying size in the kidney and the absence of a normal pelvicaliceal system. The condition is associated with ureteral or ureteropelvic atresia, and the affected kidney is nonfunctional. Evidence: TAS. Frequency: Very frequent (HP:0040281). (ORPHA:2059)
- High palate (HP:0000218): Height of the palate more than 2 SD above the mean (objective) or palatal height at the level of the first permanent molar more than twice the height of the teeth (subjective). Evidence: TAS. Frequency: Very frequent (HP:0040281). (ORPHA:2059)
- Broad forehead (HP:0000337): Width of the forehead or distance between the frontotemporales is more than two standard deviations above the mean (objective); or apparently increased distance between the two sides of the forehead. Evidence: TAS. Frequency: Very frequent (HP:0040281). (ORPHA:2059)
- Long philtrum (HP:0000343): Distance between nasal base and midline upper lip vermilion border more than 2 SD above the mean. Alternatively, an apparently increased distance between nasal base and midline upper lip vermilion border. Evidence: TAS. Frequency: Very frequent (HP:0040281). (ORPHA:2059)
- Micrognathia (HP:0000347): Developmental hypoplasia of the mandible. Evidence: TAS. Frequency: Very frequent (HP:0040281). (ORPHA:2059)
- Wide nasal bridge (HP:0000431): Increased breadth of the nasal bridge (and with it, the nasal root). Evidence: TAS. Frequency: Very frequent (HP:0040281). (ORPHA:2059)
- Short neck (HP:0000470): Diminished length of the neck. Evidence: TAS. Frequency: Very frequent (HP:0040281). (ORPHA:2059)
- Congenital diaphragmatic hernia (HP:0000776): The presence of a hernia of the diaphragm present at birth. Evidence: TAS. Frequency: Very frequent (HP:0040281). (ORPHA:2059)
- Intellectual disability (HP:0001249): The term intellectual disability or intellectual developmental disorder is used to describe significantly sub-average intellectual and adaptive functioning based on clinical assessment and as measured by individually administered, appropriately normed, standardized and validated tests of intellectual functioning and adaptive behavior, with onset during the developmental period from infancy through adolescence. Evidence: TAS. Frequency: Very frequent (HP:0040281). (ORPHA:2059)
- Hypoplastic fingernail (HP:0001804): Underdevelopment of a fingernail. Evidence: TAS. Frequency: Very frequent (HP:0040281). (ORPHA:2059)
- Pulmonary hypoplasia (HP:0002089). Evidence: TAS. Frequency: Very frequent (HP:0040281). (ORPHA:2059)
- Aplasia/Hypoplasia of the nipples (HP:0006709). Evidence: TAS. Frequency: Very frequent (HP:0040281). (ORPHA:2059)
- Tented upper lip vermilion (HP:0010804): Triangular appearance of the oral aperture with the apex in the midpoint of the upper vermilion and the lower vermilion forming the base. Evidence: TAS. Frequency: Very frequent (HP:0040281). (ORPHA:2059)
- Severe global developmental delay (HP:0011344): A severe delay in the achievement of motor or mental milestones in the domains of development of a child. Evidence: TAS. Frequency: Very frequent (HP:0040281). (ORPHA:2059)
- Cryptorchidism (HP:0000028): Testis in inguinal canal. That is, absence of one or both testes from the scrotum owing to failure of the testis or testes to descend through the inguinal canal to the scrotum. Evidence: TAS. Frequency: Frequent (HP:0040282). (ORPHA:2059)
- Wide mouth (HP:0000154): Distance between the oral commissures more than 2 SD above the mean. Alternatively, an apparently increased width of the oral aperture (subjective). Evidence: TAS. Frequency: Frequent (HP:0040282). (ORPHA:2059)
- Median cleft upper lip (HP:0000161): A type of cleft lip presenting as a midline (median) gap in the upper lip. Evidence: TAS. Frequency: Frequent (HP:0040282). (ORPHA:2059)
- Cleft palate (HP:0000175): Cleft palate is a developmental defect of the palate resulting from a failure of fusion of the palatine processes and manifesting as a separation of the roof of the mouth (soft and hard palate). Evidence: TAS. Frequency: Frequent (HP:0040282). (ORPHA:2059)
- Coarse facial features (HP:0000280): Absence of fine and sharp appearance of brows, nose, lips, mouth, and chin, usually because of rounded and heavy features or thickened skin with or without thickening of subcutaneous and bony tissues. Evidence: TAS. Frequency: Frequent (HP:0040282). (ORPHA:2059)
- Hypertelorism (HP:0000316): Interpupillary distance more than 2 SD above the mean (alternatively, the appearance of an increased interpupillary distance or widely spaced eyes). Evidence: TAS. Frequency: Frequent (HP:0040282). (ORPHA:2059)
- Anteverted nares (HP:0000463): Anteriorly-facing nostrils viewed with the head in the Frankfurt horizontal and the eyes of the observer level with the eyes of the subject. This gives the appearance of an upturned nose (upturned nasal tip). Evidence: TAS. Frequency: Frequent (HP:0040282). (ORPHA:2059)
- Thickened nuchal skin fold (HP:0000474): A thickening of the skin thickness in the posterior aspect of the fetal neck. A nuchal fold (NF) measurement is obtained in a transverse section of the fetal head at the level of the cavum septum pellucidum and thalami, angled posteriorly to include the cerebellum. The measurement is taken from the outer edge of the occiput bone to the outer skin limit directly in the midline. An NF measurement greater than 5 mm at 14 to 17+6 weeks of gestation, or 6 mm at 18 to 28 weeks has been associated with a markedly increased risk for Down syndrome. Evidence: TAS. Frequency: Frequent (HP:0040282). (ORPHA:2059)
- Seizure (HP:0001250): A seizure is an intermittent abnormality of nervous system physiology characterized by a transient occurrence of signs and/or symptoms due to abnormal excessive or synchronous neuronal activity in the brain. Evidence: TAS. Frequency: Frequent (HP:0040282). (ORPHA:2059)
- Agenesis of corpus callosum (HP:0001274): Absence of the corpus callosum as a result of the failure of the corpus callosum to develop, which can be the result of a failure in any one of the multiple steps of callosal development including cellular proliferation and migration, axonal growth or glial patterning at the midline. Evidence: TAS. Frequency: Frequent (HP:0040282). (ORPHA:2059)
- Polyhydramnios (HP:0001561): The presence of excess amniotic fluid in the uterus during pregnancy. Evidence: TAS. Frequency: Frequent (HP:0040282). (ORPHA:2059)
- Tetralogy of Fallot (HP:0001636): A congenital cardiac malformation comprising pulmonary stenosis, overriding aorta, ventricular septum defect, and right ventricular hypertrophy. The diagnosis of TOF is made if at least three of the four above mentioned features are present. Evidence: TAS. Frequency: Frequent (HP:0040282). (ORPHA:2059)
- Abnormal cardiac septum morphology (HP:0001671): An anomaly of the intra-atrial or intraventricular septum. Evidence: TAS. Frequency: Frequent (HP:0040282). (ORPHA:2059)
- Ventriculomegaly (HP:0002119): An increase in size of the ventricular system of the brain. Evidence: TAS. Frequency: Frequent (HP:0040282). (ORPHA:2059)
- Cerebral cortical atrophy (HP:0002120): Atrophy of the cortex of the cerebrum. Evidence: TAS. Frequency: Frequent (HP:0040282). (ORPHA:2059)
- Clinodactyly of the 5th finger (HP:0004209): Clinodactyly refers to a bending or curvature of the fifth finger in the radial direction (i.e., towards the 4th finger). Evidence: TAS. Frequency: Frequent (HP:0040282). (ORPHA:2059)
- Wide intermamillary distance (HP:0006610): A larger than usual distance between the left and right nipple. Evidence: TAS. Frequency: Frequent (HP:0040282). (ORPHA:2059)
- Corneal opacity (HP:0007957): A reduction of corneal clarity. Evidence: TAS. Frequency: Frequent (HP:0040282). (ORPHA:2059)
- Short distal phalanx of finger (HP:0009882): Short distance from the end of the finger to the most distal interphalangeal crease or the distal interphalangeal joint flexion point. That is, hypoplasia of one or more of the distal phalanx of finger. Evidence: TAS. Frequency: Frequent (HP:0040282). (ORPHA:2059)
- Non-midline cleft of the upper lip (HP:0100335): Clefting (gap or groove) of the upper lip affecting the lateral portions of the upper lip rather than the midline/median region. Evidence: TAS. Frequency: Frequent (HP:0040282). (ORPHA:2059)
- Hypospadias (HP:0000047): Abnormal position of urethral meatus on the ventral penile shaft (underside) characterized by displacement of the urethral meatus from the tip of the glans penis to the ventral surface of the penis, scrotum, or perineum. Evidence: TAS. Frequency: Occasional (HP:0040283). (ORPHA:2059)
- Vesicoureteral reflux (HP:0000076): Abnormal (retrograde) movement of urine from the bladder into ureters or kidneys related to inadequacy of the valvular mechanism at the ureterovesicular junction or other causes. Evidence: TAS. Frequency: Occasional (HP:0040283). (ORPHA:2059)
- Hydronephrosis (HP:0000126): Severe distention of the kidney with dilation of the renal pelvis and calices. Evidence: TAS. Frequency: Occasional (HP:0040283). (ORPHA:2059)
- Microphthalmia (HP:0000568): A developmental anomaly characterized by abnormal smallness of one or both eyes. Evidence: TAS. Frequency: Occasional (HP:0040283). (ORPHA:2059)
- Narrow chest (HP:0000774): Reduced width of the chest from side to side, associated with a reduced distance from the sternal notch to the tip of the shoulder. Evidence: TAS. Frequency: Occasional (HP:0040283). (ORPHA:2059)
- Bicornuate uterus (HP:0000813): The presence of a bicornuate uterus. Evidence: TAS. Frequency: Occasional (HP:0040283). (ORPHA:2059)
- Dandy-Walker malformation (HP:0001305): A congenital brain malformation typically characterized by incomplete formation of the cerebellar vermis, dilation of the fourth ventricle, and enlargement of the posterior fossa. In layman's terms, Dandy Walker malformation is a cyst in the cerebellum (typically symmetrical) that is involved with the fourth ventricle. This may interfere with the ability to drain cerebrospinal fluid from the brain, resulting in hydrocephalus. Dandy Walker cysts are formed during early embryonic development, while the brain forms. The cyst in the cerebellum typically has several blood vessels running through it connecting to the brain, thereby prohibiting surgical removal. Evidence: TAS. Frequency: Occasional (HP:0040283). (ORPHA:2059)
- Omphalocele (HP:0001539): A midline anterior incomplete closure of the abdominal wall in which there is herniation of the abdominal viscera into the base of the abdominal cord. Evidence: TAS. Frequency: Occasional (HP:0040283). (ORPHA:2059)
- Abnormal aortic morphology (HP:0001679): An abnormality of the aorta. Evidence: TAS. Frequency: Occasional (HP:0040283). (ORPHA:2059)
- Gastroesophageal reflux (HP:0002020): A condition in which the stomach contents leak backwards from the stomach into the esophagus through the lower esophageal sphincter. Evidence: TAS. Frequency: Occasional (HP:0040283). (ORPHA:2059)
- Anal atresia (HP:0002023): Congenital absence of the anus, i.e., the opening at the bottom end of the intestinal tract. Evidence: TAS. Frequency: Occasional (HP:0040283). (ORPHA:2059)
- Duodenal atresia (HP:0002247): A developmental defect resulting in complete obliteration of the duodenal lumen, that is, an abnormal closure of the duodenum. Evidence: TAS. Frequency: Occasional (HP:0040283). (ORPHA:2059)
- Aganglionic megacolon (HP:0002251): An abnormality resulting from a lack of intestinal ganglion cells (i.e., an aganglionic section of bowel) that results in bowel obstruction with enlargement of the colon. Evidence: TAS. Frequency: Occasional (HP:0040283). (ORPHA:2059)
- Intestinal malrotation (HP:0002566): An abnormality of the intestinal rotation and fixation that normally occurs during the development of the gut. This can lead to volvulus, or twisting of the intestine that causes obstruction and necrosis. Evidence: TAS. Frequency: Occasional (HP:0040283). (ORPHA:2059)
- Ectopic anus (HP:0004397): Abnormal displacement or malposition of the anus. Evidence: TAS. Frequency: Occasional (HP:0040283). (ORPHA:2059)
- Abnormal aortic arch morphology (HP:0012303): An anomaly of the arch of aorta. Evidence: TAS. Frequency: Occasional (HP:0040283). (ORPHA:2059)
These phenotypes are associated with the disease Fryns syndrome (ORPHA:2059).